Phenotypes associated with the disease tumor predisposition syndrome 3 (OMIM:615848):
- Melanoma (HP:0002861): The presence of a melanoma, a malignant cancer originating from pigment producing melanocytes. Melanoma can originate from the skin or the pigmented layers of the eye (the uvea). Evidence: PCS. (PMID:24686849)
- Adult onset (HP:0003581): Onset of disease manifestations in adulthood, defined here as at the age of 16 years or later. Evidence: PCS. (PMID:24686849)
- Typified by incomplete penetrance (HP:0003829): Description of conditions in which not all individuals with a given genotype exhibit the disease. Penetrance is the proportion that develop disease given a lifespan of 80 years. Evidence: PCS. (PMID:24686849)
- Gastrointestinal desmoid tumor (HP:0100245): Benign, slow-growing tumors without any metastatic potential. Despite their benign nature, they can damage nearby structures causing organ dysfunction. Histologically they resemble low-grade fibrosarcomas, but they are very locally aggressive and tend to recur even after complete resection. There is a tendency for recurrence in the setting of prior surgery and the most common localisation of these tumors is intraabdominal from smooth muscle cells of the instestine. Evidence: PCS. (PMID:37140166)
- Autosomal dominant inheritance (HP:0000006): A mode of inheritance that is observed for traits related to a gene encoded on one of the autosomes (i.e., the human chromosomes 1-22) in which a trait manifests in heterozygotes. In the context of medical genetics, an autosomal dominant disorder is caused when a single copy of the mutant allele is present. Males and females are affected equally, and can both transmit the disorder with a risk of 50% for each child of inheriting the mutant allele. Evidence: PCS. (PMID:24686849)